Phenotypes associated with the disease Uncombable hair syndrome (ORPHA:1410):
- Abnormal hair morphology (HP:0001595): An abnormality of the hair. Evidence: TAS. Frequency: Very frequent (HP:0040281). (ORPHA:1410)
- Coarse hair (HP:0002208): Hair shafts are rough in texture. Evidence: TAS. Frequency: Very frequent (HP:0040281). (ORPHA:1410)
- Woolly hair (HP:0002224): The term wooly hair refers to an abnormal variant of hair that is fine, with tightly coiled curls, and often hypopigmented. Optical microscopy may reveal the presence of tight spirals and a clear diameter reduction as compared with normal hair. Electron microscopy may show flat, oval hair shafts with reduced transversal diameter. Evidence: TAS. Frequency: Very frequent (HP:0040281). (ORPHA:1410)
- Trichodysplasia (HP:0002552): Developmental dysplasia of the hair. Evidence: TAS. Frequency: Very frequent (HP:0040281). (ORPHA:1410)
- White hair (HP:0011364): Hypopigmented hair that appears white. Evidence: TAS. Frequency: Very frequent (HP:0040281). (ORPHA:1410)
- Patchy alopecia (HP:0002232): Transient, non-scarring hair loss and preservation of the hair follicle located in in well-defined patches. Evidence: TAS. Frequency: Occasional (HP:0040283). (ORPHA:1410)